Phenotypes associated with the disease vesicoureteral reflux 1 (OMIM:193000):
- Vesicoureteral reflux (HP:0000076): Abnormal (retrograde) movement of urine from the bladder into ureters or kidneys related to inadequacy of the valvular mechanism at the ureterovesicular junction or other causes. Evidence: IEA. (OMIM:193000)
- Abnormality of the skeletal system (HP:0000924): An abnormality of the skeletal system. Evidence: IEA. (OMIM:193000)
- Non-Mendelian inheritance (HP:0001426): A mode of inheritance that depends on genetic determinants in more than one gene. Evidence: TAS. (OMIM:193000)
- Autosomal dominant inheritance (HP:0000006): A mode of inheritance that is observed for traits related to a gene encoded on one of the autosomes (i.e., the human chromosomes 1-22) in which a trait manifests in heterozygotes. In the context of medical genetics, an autosomal dominant disorder is caused when a single copy of the mutant allele is present. Males and females are affected equally, and can both transmit the disorder with a risk of 50% for each child of inheriting the mutant allele. Evidence: TAS. (OMIM:193000)